- Atypical behavior (HP:0000708): Atypical behavior is an abnormality in a person's actions that can be controlled or modulated by the will of the individual. While abnormal behaviors can be difficult to control, they are distinct from other abnormal actions that cannot be affected by the individual's will. Evidence: IEA. (DECIPHER:51)
- Cleft palate (HP:0000175): Cleft palate is a developmental defect of the palate resulting from a failure of fusion of the palatine processes and manifesting as a separation of the roof of the mouth (soft and hard palate). Evidence: IEA. (DECIPHER:51)
- Inguinal hernia (HP:0000023): Protrusion of the contents of the abdominal cavity through the inguinal canal. Evidence: IEA. (DECIPHER:51)
- Short stature (HP:0004322): A height below that which is expected according to age and gender norms. Although there is no universally accepted definition of short stature, many refer to "short stature" as height more than 2 standard deviations below the mean for age and gender (or below the 3rd percentile for age and gender dependent norms). Evidence: IEA. (DECIPHER:51)
- Seizure (HP:0001250): A seizure is an intermittent abnormality of nervous system physiology characterized by a transient occurrence of signs and/or symptoms due to abnormal excessive or synchronous neuronal activity in the brain. Evidence: IEA. (DECIPHER:51)
- Feeding difficulties in infancy (HP:0008872): Impaired feeding performance of an infant as manifested by difficulties such as weak and ineffective sucking, brief bursts of sucking, and falling asleep during sucking. There may be difficulties with chewing or maintaining attention. Evidence: IEA. (DECIPHER:51)
- High palate (HP:0000218): Height of the palate more than 2 SD above the mean (objective) or palatal height at the level of the first permanent molar more than twice the height of the teeth (subjective). Evidence: IEA. (DECIPHER:51)
- Intellectual disability (HP:0001249): The term intellectual disability or intellectual developmental disorder is used to describe significantly sub-average intellectual and adaptive functioning based on clinical assessment and as measured by individually administered, appropriately normed, standardized and validated tests of intellectual functioning and adaptive behavior, with onset during the developmental period from infancy through adolescence. Evidence: IEA. (DECIPHER:51)
These phenotypes are associated with the disease 2q33.1 microdeletion syndrome (DECIPHER:51).